Phenotypes associated with the disease Binder syndrome (OMIM:155050):
- Short columella (HP:0002000): Reduced distance from the anterior border of the naris to the subnasale. Evidence: IEA. (OMIM:155050)
- Short nose (HP:0003196): Distance from nasion to subnasale more than two standard deviations below the mean, or alternatively, an apparently decreased length from the nasal root to the nasal tip. Evidence: IEA. (OMIM:155050)
- Patchy distortion of vertebrae (HP:0004609). Evidence: IEA. (OMIM:155050)
- Short distal phalanx of finger (HP:0009882): Short distance from the end of the finger to the most distal interphalangeal crease or the distal interphalangeal joint flexion point. That is, hypoplasia of one or more of the distal phalanx of finger. Evidence: TAS. (OMIM:155050)
- Dental malocclusion (HP:0000689): Dental malocclusion refers to an abnormality of the occlusion, or alignment, of the teeth and the way the upper and lower teeth fit together, resulting in overcrowding of teeth or in abnormal bite patterns. Evidence: IEA. (OMIM:155050)
- Depressed nasal bridge (HP:0005280): Posterior positioning of the nasal root in relation to the overall facial profile for age. Evidence: IEA. (OMIM:155050)
- Large earlobe (HP:0009748): Increased volume of the earlobe, that is, abnormally prominent ear lobules. Evidence: IEA. (OMIM:155050)
- Vertebral clefting (HP:0008428): Schisis (cleft or cleavage) of vertebral bodies. Evidence: TAS. (OMIM:155050)